- Hypogonadotropic hypogonadism (HP:0000044): Hypogonadotropic hypogonadism is characterized by reduced function of the gonads (testes in males or ovaries in females) and results from the absence of the gonadal stimulating pituitary hormones: follicle stimulating hormone (FSH) and luteinizing hormone (LH). Evidence: IEA. (OMIM:604292)
- Anal stenosis (HP:0002025): Abnormal narrowing of the anal opening. Evidence: PCS. Frequency: 2/6. (PMID:17431922)
- Facial hirsutism (HP:0009937): Excess facial hair. Evidence: PCS. Frequency: 2/5. (PMID:17431922)
- Toe syndactyly (HP:0001770): Webbing or fusion of the toes, involving soft parts only or including bone structure. Bony fusions are referred to as "bony" Syndactyly if the fusion occurs in a radio-ulnar axis. Fusions of bones of the toes in a proximo-distal axis are referred to as "Symphalangism". Evidence: IEA. (OMIM:604292)
- Hearing impairment (HP:0000365): A decreased magnitude of the sensory perception of sound. Evidence: IEA. (OMIM:604292)
- Infantile onset (HP:0003593): Onset of signs or symptoms of disease between 28 days to one year of life. Evidence: PCS. Frequency: 2/6. (PMID:17431922)
- Split hand (HP:0001171): A condition in which middle parts of the hand (fingers and metacarpals) are missing giving a cleft appearance. The severity is very variable ranging from slightly hypoplastic middle fingers over absent middle fingers as far as oligo- or monodactyl hands. Evidence: PCS. Frequency: 1/6. (PMID:17431922)
- Duplicated collecting system (HP:0000081): A duplication of the collecting system of the kidney, defined as a kidney with two (instead of, normally, one) pyelocaliceal systems. The pyelocaliceal system is comprised of the renal pelvis and calices. The duplicated renal collecting system can be associated with a single ureter or with double ureters. In the latter case, the two ureters empty separately into the bladder or fuse to form a single ureteral orifice. Evidence: IEA. (OMIM:604292)
- Sparse eyebrow (HP:0045075): Decreased density/number of eyebrow hairs. Evidence: PCS. Frequency: 1/6. (PMID:17431922)
- Childhood onset (HP:0011463): Onset of disease at the age of between 1 and 5 years. Evidence: PCS. Frequency: 3/6. (PMID:17431922)
- Blue irides (HP:0000635): A markedly blue coloration of the iris. Evidence: IEA. (OMIM:604292)
- Depressed nasal tip (HP:0000437): Decreased distance from the nasal tip to the nasal base. Evidence: IEA. (OMIM:604292)
- Nail pits (HP:0001803): Small (typically about 1 mm or less in size) depressions on the dorsal nail surface. Evidence: IEA. (OMIM:604292)
- Intellectual disability (HP:0001249): The term intellectual disability or intellectual developmental disorder is used to describe significantly sub-average intellectual and adaptive functioning based on clinical assessment and as measured by individually administered, appropriately normed, standardized and validated tests of intellectual functioning and adaptive behavior, with onset during the developmental period from infancy through adolescence. Evidence: TAS. Frequency: 7%. (OMIM:604292)
- Sparse axillary hair (HP:0002215): Reduced number or density of axillary hair. Evidence: IEA. (OMIM:604292)
- Cleft palate (HP:0000175): Cleft palate is a developmental defect of the palate resulting from a failure of fusion of the palatine processes and manifesting as a separation of the roof of the mouth (soft and hard palate). Evidence: PCS. Frequency: 1/6. (PMID:17431922)
- Micropenis (HP:0000054): Abnormally small penis. At birth, the normal penis is about 3 cm (stretched length from pubic tubercle to tip of penis) with micropenis less than 2.0-2.5 cm. Evidence: IEA. (OMIM:604292)
- Choanal atresia (HP:0000453): Absence or abnormal closure of the choana (the posterior nasal aperture). Most embryologists believe that posterior choanal atresia results from a failure of rupture between the 35th and 38th day of fetal life of the partition which separates the bucconasal or buccopharyngeal membranes. The resultant choanal atresia may be unilateral or bilateral, bony or membranous, complete or incomplete. In over 90 per cent of cases the obstruction is bony, while in the remainder it is membranous. The bony type of atresia is commonly located 1-2 mm. anterior to the posterior edge of the hard palate, and the osseous septum varies in thickness from 1 to 10 mm. In the membranous form of choanal atresia the obstruction usually occurs further posteriorly. In approximately one third of cases the atresia is bilateral. Evidence: IEA. (OMIM:604292)
- Microdontia (HP:0000691): Decreased size of the teeth, which can be defined as a mesiodistal tooth diameter (width) more than 2 SD below mean. Alternatively, an apparently decreased maximum width of tooth. Evidence: IEA. (OMIM:604292)
- Ectrodactyly (HP:0100257): A condition in which middle parts of the hands and/or feet (digits and meta-carpals and -tarsals) are missing giving a cleft appearance. The severity is very variable ranging from slightly hypoplastic 3rd toe/fingers over absent 2nd or 3rd toes/fingers as far as oligo- or monodactyl hands and/or feet. Evidence: TAS. (OMIM:604292)
- Abnormal nasopharynx morphology (HP:0001739): A structural anomaly of the nasopharynx. Evidence: IEA. (OMIM:604292)
- Ectodermal dysplasia (HP:0000968): Ectodermal dysplasia is a group of conditions in which there is abnormal development of the skin, hair, nails, teeth, or sweat glands. Evidence: TAS. (OMIM:604292)
- Hypoplasia of the maxilla (HP:0000327): Abnormally small dimension of the Maxilla. Usually creating a malocclusion or malalignment between the upper and lower teeth or resulting in a deficient amount of projection of the base of the nose and lower midface region. Evidence: IEA. (OMIM:604292)
- Nail dystrophy (HP:0008404): Onychodystrophy (nail dystrophy) refers to nail changes apart from changes of the color (nail dyschromia) and involves partial or complete disruption of the various keratinous layers of the nail plate. Evidence: PCS. (PMID:10535733)
- Generalized hypopigmentation (HP:0007513). Evidence: IEA. (OMIM:604292)
- Lacrimal duct stenosis (HP:0007678): Narrowing of a tear duct (lacrimal duct). Evidence: PCS. Frequency: 6/6. (PMID:17431922)
- Autosomal dominant inheritance (HP:0000006): A mode of inheritance that is observed for traits related to a gene encoded on one of the autosomes (i.e., the human chromosomes 1-22) in which a trait manifests in heterozygotes. In the context of medical genetics, an autosomal dominant disorder is caused when a single copy of the mutant allele is present. Males and females are affected equally, and can both transmit the disorder with a risk of 50% for each child of inheriting the mutant allele. Evidence: PCS. (PMID:10535733)
- Cleft upper lip (HP:0000204): A gap or groove in the upper lip. This is a congenital defect resulting from nonfusion of tissues of the lip during embryonal development. Evidence: PCS. Frequency: 0/6. (PMID:17431922)
- Sparse pubic hair (HP:0002225): Reduced number or density of pubic hair. Evidence: IEA. (OMIM:604292)
- Hydronephrosis (HP:0000126): Severe distention of the kidney with dilation of the renal pelvis and calices. Evidence: IEA. (OMIM:604292)
- Hyperkeratosis (HP:0000962): Hyperkeratosis is a histopathological term defining a thickened stratum corneum and may be present in many different skin conditions, with many possible overlaps. Hyperkeratosis refers to the increased thickness of the stratum corneum, the outer layer of the skin. Hyperkeratosis is subclassified as orthokeratotic or parakeratotic. Orthokeratotic hyperkeratosis refers to the thickening of the keratin layer with preserved keratinocyte maturation, while parakeratotic hyperkeratosis shows retained nuclei as a sign of delayed maturation of keratinocytes. Evidence: IEA. (OMIM:604292)
- Megacystis (HP:0000021): Dilatation of the bladder postnatally. Evidence: IEA. (OMIM:604292)
- Congenital onset (HP:0003577): A phenotypic abnormality that is present at birth. Evidence: PCS. Frequency: 1/6. (PMID:17431922)
- Transverse vaginal septum (HP:0000145). Evidence: IEA. (OMIM:604292)
- Fair hair (HP:0002286): A lesser degree of hair pigmentation than would otherwise be expected. Evidence: IEA. (OMIM:604292)
- Blepharophimosis (HP:0000581): A fixed reduction in the vertical distance between the upper and lower eyelids with short palpebral fissures. Evidence: IEA. (OMIM:604292)
- Selective tooth agenesis (HP:0001592): Agenesis specifically affecting one of the classes incisor, premolar, or molar. Evidence: IEA. (OMIM:604292)
- Microtia (HP:0008551): Underdevelopment of the external ear. Evidence: IEA. (OMIM:604292)
- Photophobia (HP:0000613): Excessive sensitivity to light with the sensation of discomfort or pain in the eyes due to exposure to bright light. Evidence: IEA. (OMIM:604292)
- Xerostomia (HP:0000217): Dryness of the mouth due to salivary gland dysfunction. Evidence: IEA. (OMIM:604292)
- Bladder diverticulum (HP:0000015): Diverticulum (sac or pouch) in the wall of the urinary bladder. Evidence: IEA. (OMIM:604292)
- Hypoplastic nipples (HP:0002557): Underdevelopment of the nipple. Evidence: PCS. Frequency: 6/6. (PMID:17431922)
- Sparse eyelashes (HP:0000653): Decreased density/number of eyelashes. Evidence: PCS. Frequency: 1/6. (PMID:17431922)
- Blepharitis (HP:0000498): Inflammation of the eyelids. Evidence: IEA. (OMIM:604292)
- Anteriorly placed anus (HP:0001545): Anterior malposition of the anus. Evidence: PCS. Frequency: 2/6. (PMID:17431922)
- Absence of Stensen duct (HP:0000198). Evidence: IEA. (OMIM:604292)
- Renal dysplasia (HP:0000110): The presence of developmental dysplasia of the kidney. Evidence: IEA. (OMIM:604292)
- Carious teeth (HP:0000670): Caries is a multifactorial bacterial infection affecting the structure of the tooth. This term has been used to describe the presence of more than expected dental caries. Evidence: IEA. (OMIM:604292)
- Vesicoureteral reflux (HP:0000076): Abnormal (retrograde) movement of urine from the bladder into ureters or kidneys related to inadequacy of the valvular mechanism at the ureterovesicular junction or other causes. Evidence: IEA. (OMIM:604292)
- Hydroureter (HP:0000072): The distention of the ureter with urine. Evidence: IEA. (OMIM:604292)
- Malar flattening (HP:0000272): Underdevelopment of the malar prominence of the jugal bone (zygomatic bone in mammals), appreciated in profile, frontal view, and/or by palpation. Evidence: IEA. (OMIM:604292)
- Hypoplastic sacrum (HP:0004590): A developmental defect characterized by undergrowth of the sacrum, which is a large, triangular bone at the base of the spine that forms by the fusing of the sacral vertebrae (S1-S5). Evidence: PCS. Frequency: 1/3. (PMID:17431922)
- Ureterocele (HP:0000070): A ureterocele is a congenital saccular dilatation of the distal segment of the ureter. Evidence: IEA. (OMIM:604292)
- Split foot (HP:0001839): A condition in which middle parts of the foot (toes and metatarsals) are missing giving a cleft appearance. The severity is very variable ranging from slightly hypoplastic 3rd toe over absent 2nd or 3rd toes as far as oligo- or monodactyl feet. Evidence: PCS. Frequency: 1/6. (PMID:17431922)
- Urethral stenosis (HP:0008661): Abnormal narrowing of the urethra. Evidence: IEA. (OMIM:604292)
- Sparse scalp hair (HP:0002209): Decreased number of hairs per unit area of skin of the scalp. Evidence: IEA. (OMIM:604292)
- Decreased response to growth hormone stimulation test (HP:0000824): Insufficient responses to growth hormone (GH) provocation tests. GH deficiency is defined as a serum peak GH concentration less than 10 ng/mL on provocation with a combination of at least two separate stimulation tests. Evidence: IEA. (OMIM:604292)
- Dacryocystitis (HP:0000620): Inflammation of the nasolacrimal sac. Evidence: IEA. (OMIM:604292)
- Cryptorchidism (HP:0000028): Testis in inguinal canal. That is, absence of one or both testes from the scrotum owing to failure of the testis or testes to descend through the inguinal canal to the scrotum. Evidence: IEA. (OMIM:604292)
- Central diabetes insipidus (HP:0000863): A form of diabetes insipidus related to a failure of vasopressin (AVP) release from the hypothalamus. Evidence: IEA. (OMIM:604292)
- Renal agenesis (HP:0000104): Agenesis, that is, failure of the kidney to develop during embryogenesis and development. Evidence: IEA. (OMIM:604292)
These phenotypes are associated with the disease ectrodactyly, ectodermal dysplasia, and cleft lip-palate syndrome 3 (OMIM:604292).